Phenotypes associated with the disease Alar cartilages hypoplasia-coloboma-telecanthus syndrome (ORPHA:2007):
- Hypertelorism (HP:0000316): Interpupillary distance more than 2 SD above the mean (alternatively, the appearance of an increased interpupillary distance or widely spaced eyes). Evidence: TAS. Frequency: Very frequent (HP:0040281). (ORPHA:2007)
- Underdeveloped nasal alae (HP:0000430): Thinned, deficient, or excessively arched ala nasi. Evidence: TAS. Frequency: Very frequent (HP:0040281). (ORPHA:2007)
- Wide nasal bridge (HP:0000431): Increased breadth of the nasal bridge (and with it, the nasal root). Evidence: TAS. Frequency: Very frequent (HP:0040281). (ORPHA:2007)
- Convex nasal ridge (HP:0000444): Nasal ridge curving anteriorly to an imaginary line that connects the nasal root and tip. The nose appears often also prominent, and the columella low. Evidence: TAS. Frequency: Very frequent (HP:0040281). (ORPHA:2007)
- Telecanthus (HP:0000506): Distance between the inner canthi more than two standard deviations above the mean (objective); or, apparently increased distance between the inner canthi. Evidence: TAS. Frequency: Very frequent (HP:0040281). (ORPHA:2007)
- Cleft ala nasi (HP:0003191): The presence of a notch in the margin of the ala nasi. Evidence: TAS. Frequency: Very frequent (HP:0040281). (ORPHA:2007)
- Non-midline cleft of the upper lip (HP:0100335): Clefting (gap or groove) of the upper lip affecting the lateral portions of the upper lip rather than the midline/median region. Evidence: TAS. Frequency: Very frequent (HP:0040281). (ORPHA:2007)